Phenotypes associated with the disease thrombocytopenia with elevated serum IgA and renal disease (OMIM:314000):
- Glomerulonephritis (HP:0000099): Inflammation of the renal glomeruli. Evidence: IEA. (OMIM:314000)
- Abnormal bleeding (HP:0001892): An abnormal susceptibility to bleeding, often referred to as a bleeding diathesis. A bleeding diathesis may be related to vascular, platelet and coagulation defects. Evidence: IEA. (OMIM:314000)
- Hematuria (HP:0000790): The presence of blood in the urine. Hematuria may be gross hematuria (visible to the naked eye) or microscopic hematuria (detected by dipstick or microscopic examination of the urine). Evidence: IEA. (OMIM:314000)
- Increased circulating IgA concentration (HP:0003261): An abnormally increased level of immunoglobulin A in blood. Evidence: IEA. (OMIM:314000)
- X-linked inheritance (HP:0001417): A mode of inheritance that is observed for traits related to a gene encoded on the X chromosome. Evidence: IEA. (OMIM:314000)
- Thrombocytopenia (HP:0001873): A reduction in the number of circulating thrombocytes. Evidence: IEA. (OMIM:314000)